Phenotypes associated with the disease muscular dystrophy, adult-onset, with leukoencephalopathy (OMIM:253590):
- Seizure (HP:0001250): A seizure is an intermittent abnormality of nervous system physiology characterized by a transient occurrence of signs and/or symptoms due to abnormal excessive or synchronous neuronal activity in the brain. Evidence: IEA. (OMIM:253590)
- Gait ataxia (HP:0002066): A type of ataxia characterized by the impairment of the ability to coordinate the movements required for normal walking. Gait ataxia is characteirzed by a wide-based staggering gait with a tendency to fall. Evidence: IEA. (OMIM:253590)
- Leukoencephalopathy (HP:0002352): This term describes abnormality of the white matter of the cerebrum resulting from damage to the myelin sheaths of nerve cells. Evidence: IEA. (OMIM:253590)
- Muscular dystrophy (HP:0003560): The term dystrophy means abnormal growth. However, muscular dystrophy is used to describe primary myopathies with a genetic basis and a progressive course characterized by progressive skeletal muscle weakness and wasting, defects in muscle proteins, and histological features of muscle fiber degeneration (necrosis) and regeneration. If possible, it is preferred to use other HPO terms to describe the precise phenotypic abnormalities. Evidence: IEA. (OMIM:253590)
- Autosomal recessive inheritance (HP:0000007): A mode of inheritance that is observed for traits related to a gene encoded on one of the autosomes (i.e., the human chromosomes 1-22) in which a trait manifests in individuals with two pathogenic alleles, either homozygotes (two copies of the same mutant allele) or compound heterozygotes (whereby each copy of a gene has a distinct mutant allele). Evidence: IEA. (OMIM:253590)
- Muscle weakness (HP:0001324): Reduced strength of muscles. Evidence: IEA. (OMIM:253590)